Phenotypes associated with the disease Syndactyly type 1 (ORPHA:93402):
- Toe syndactyly (HP:0001770): Webbing or fusion of the toes, involving soft parts only or including bone structure. Bony fusions are referred to as "bony" Syndactyly if the fusion occurs in a radio-ulnar axis. Fusions of bones of the toes in a proximo-distal axis are referred to as "Symphalangism". Evidence: TAS. Frequency: Very frequent (HP:0040281). (ORPHA:93402)
- 2-3 toe syndactyly (HP:0004691): Syndactyly with fusion of toes two and three. Evidence: TAS. Frequency: Very frequent (HP:0040281). (ORPHA:93402)
- 3-4 finger osseus syndactyly (HP:0006097): Fusion of the third (middle) and fourth (ring) finger, involving soft parts and including fusion of individual finger bones. Evidence: TAS. Frequency: Very frequent (HP:0040281). (ORPHA:93402)
- Finger symphalangism (HP:0009700): An abnormal union between bones or parts of bones of the fingers. The synonymous term "symphalangism of the hand" may be translated as fusions of bones of varying digree, that involve at least one phalangeal bone of the hand. If bony fusions are referred to as "Symphalangism" the fusion occurs in a proximo-distal axis. Fusions of bones of the fingers in a radio-ulnar axis are referred to as "bony" Syndactyly. Evidence: TAS. Frequency: Occasional (HP:0040283). (ORPHA:93402)